Phenotypes associated with the disease severe growth deficiency-strabismus-extensive dermal melanocytosis-intellectual disability syndrome (OMIM:617051):
- Microcephaly (HP:0000252): Head circumference below 2 standard deviations below the mean for age and gender. Evidence: PCS. Frequency: 2/3. (PMID:27055666)
- Cerebral atrophy (HP:0002059): Atrophy (wasting, decrease in size of cells or tissue) affecting the cerebrum. Evidence: PCS. Frequency: 1/3. (PMID:27055666)
- Strabismus (HP:0000486): A misalignment of the eyes so that the visual axes deviate from bifoveal fixation. The classification of strabismus may be based on a number of features including the relative position of the eyes, whether the deviation is latent or manifest, intermittent or constant, concomitant or otherwise and according to the age of onset and the relevance of any associated refractive error. Evidence: PCS. Frequency: 3/3. (PMID:27055666)
- Seizure (HP:0001250): A seizure is an intermittent abnormality of nervous system physiology characterized by a transient occurrence of signs and/or symptoms due to abnormal excessive or synchronous neuronal activity in the brain. Evidence: PCS. Frequency: 1/3. (PMID:27055666)
- Profound intellectual disability (HP:0002187): Profound intellectual disability (ID) is defined as a type of ID characterized by profoundly sub-average adaptive functioning and intellectual functioning, with an intelligence quotient (IQ) below 20. Evidence: PCS. Frequency: 1/3. (PMID:27055666)
- Global developmental delay (HP:0001263): A delay in the achievement of motor or mental milestones in the domains of development of a child, including motor skills, speech and language, cognitive skills, and social and emotional skills. This term should only be used to describe children younger than five years of age. Evidence: PCS. Frequency: 3/3. (PMID:27055666)
- Hypotonia (HP:0001252): Hypotonia is an abnormally low muscle tone (the amount of tension or resistance to movement in a muscle). Even when relaxed, muscles have a continuous and passive partial contraction which provides some resistance to passive stretching. Hypotonia thus manifests as diminished resistance to passive stretching. Hypotonia is not the same as muscle weakness, although the two conditions can co-exist. Evidence: PCS. Frequency: 1/3. (PMID:27055666)
- Blue sclerae (HP:0000592): An abnormal bluish coloration of the sclera. Evidence: PCS. Frequency: 3/3. (PMID:27055666)
- Infantile onset (HP:0003593): Onset of signs or symptoms of disease between 28 days to one year of life. Evidence: PCS. Frequency: 3/3. (PMID:27055666)
- Coarse facial features (HP:0000280): Absence of fine and sharp appearance of brows, nose, lips, mouth, and chin, usually because of rounded and heavy features or thickened skin with or without thickening of subcutaneous and bony tissues. Evidence: PCS. Frequency: 2/3. (PMID:27055666)
- Severe intellectual disability (HP:0010864): Severe intellectual disability (ID) is defined as a type of ID characterized by severely sub-average adaptive functioning and intellectual functioning, with an intelligence quotient (IQ) the range of 20-34. Evidence: PCS. Frequency: 2/3. (PMID:27055666)
- Reduced social responsiveness (HP:0012760): A reduced ability to participate in the back-and-forth flow of social interaction appropriate to culture and developmental level, which is normally characterized by an influence of the behavior of one person on the behavior of another person. This results in difficulty interacting with others through emotional, physical, or verbal communication. Evidence: PCS. Frequency: 1/3. (PMID:27055666)
- Arachnoid cyst (HP:0100702): An extra-parenchymal and intra-arachnoidal collection of fluid with a composition similar to that of cerebrospinal fluid. Evidence: PCS. Frequency: 2/3. (PMID:27055666)
- Autosomal recessive inheritance (HP:0000007): A mode of inheritance that is observed for traits related to a gene encoded on one of the autosomes (i.e., the human chromosomes 1-22) in which a trait manifests in individuals with two pathogenic alleles, either homozygotes (two copies of the same mutant allele) or compound heterozygotes (whereby each copy of a gene has a distinct mutant allele). Evidence: PCS. (PMID:27055666)
- Ventriculomegaly (HP:0002119): An increase in size of the ventricular system of the brain. Evidence: PCS. Frequency: 1/3. (PMID:27055666)